- Seizure (HP:0001250): A seizure is an intermittent abnormality of nervous system physiology characterized by a transient occurrence of signs and/or symptoms due to abnormal excessive or synchronous neuronal activity in the brain. Evidence: TAS. Frequency: Frequent (HP:0040282). (ORPHA:99843)
- Intrauterine growth retardation (HP:0001511): An abnormal restriction of fetal growth with fetal weight below the tenth percentile for gestational age. Evidence: TAS. Frequency: Frequent (HP:0040282). (ORPHA:99843)
- Small for gestational age (HP:0001518): Smaller than normal size according to sex and gestational age related norms, defined as a weight below the 10th percentile for the gestational age. Evidence: TAS. Frequency: Frequent (HP:0040282). (ORPHA:99843)
- Microcytic anemia (HP:0001935): A kind of anemia in which the volume of the red blood cells is reduced. Evidence: TAS. Frequency: Frequent (HP:0040282). (ORPHA:99843)
- Recurrent fever (HP:0001954): Periodic (episodic or recurrent) bouts of fever. Evidence: TAS. Frequency: Frequent (HP:0040282). (ORPHA:99843)
- Cerebral atrophy (HP:0002059): Atrophy (wasting, decrease in size of cells or tissue) affecting the cerebrum. Evidence: TAS. Frequency: Frequent (HP:0040282). (ORPHA:99843)
- Sleep disturbance (HP:0002360): An abnormal pattern in the quality, quantity, or characteristics of sleep. Evidence: TAS. Frequency: Frequent (HP:0040282). (ORPHA:99843)
- Severe intellectual disability (HP:0010864): Severe intellectual disability (ID) is defined as a type of ID characterized by severely sub-average adaptive functioning and intellectual functioning, with an intelligence quotient (IQ) the range of 20-34. Evidence: TAS. Frequency: Frequent (HP:0040282). (ORPHA:99843)
- Recurrent urinary tract infections (HP:0000010): Repeated infections of the urinary tract. Evidence: TAS. Frequency: Occasional (HP:0040283). (ORPHA:99843)
- Severe periodontitis (HP:0000166): Increased susceptibility to periodontitis, as manifested by severe periodontal infection with rapid alveolar bone loss, tooth mobility, and premature tooth exfoliation. Evidence: TAS. Frequency: Occasional (HP:0040283). (ORPHA:99843)
- Narrow palate (HP:0000189): Width of the palate more than 2 SD below the mean (objective) or apparently decreased palatal width (subjective). Evidence: TAS. Frequency: Occasional (HP:0040283). (ORPHA:99843)
- Gingival overgrowth (HP:0000212): Hyperplasia of the gingiva (that is, a thickening of the soft tissue overlying the alveolar ridge. The degree of thickening ranges from involvement of the interdental papillae alone to gingival overgrowth covering the entire tooth crown. Evidence: TAS. Frequency: Occasional (HP:0040283). (ORPHA:99843)
- Microcephaly (HP:0000252): Head circumference below 2 standard deviations below the mean for age and gender. Evidence: TAS. Frequency: Occasional (HP:0040283). (ORPHA:99843)
- Low anterior hairline (HP:0000294): Distance between the hairline (trichion) and the glabella (the most prominent point on the frontal bone above the root of the nose), in the midline, more than two SD below the mean. Alternatively, an apparently decreased distance between the hairline and the glabella. Evidence: TAS. Frequency: Occasional (HP:0040283). (ORPHA:99843)
- Mandibular prognathia (HP:0000303): Abnormal prominence of the chin related to increased length of the mandible. Evidence: TAS. Frequency: Occasional (HP:0040283). (ORPHA:99843)
- Hypertelorism (HP:0000316): Interpupillary distance more than 2 SD above the mean (alternatively, the appearance of an increased interpupillary distance or widely spaced eyes). Evidence: TAS. Frequency: Occasional (HP:0040283). (ORPHA:99843)
- Small earlobe (HP:0000385): Reduced volume of the earlobe. Evidence: TAS. Frequency: Occasional (HP:0040283). (ORPHA:99843)
- Recurrent otitis media (HP:0000403): Increased susceptibility to otitis media, as manifested by recurrent episodes of otitis media. Evidence: TAS. Frequency: Occasional (HP:0040283). (ORPHA:99843)
- Conductive hearing impairment (HP:0000405): An abnormality of vibrational conductance of sound to the inner ear leading to impairment of sensory perception of sound. Evidence: TAS. Frequency: Occasional (HP:0040283). (ORPHA:99843)
- Wide nasal bridge (HP:0000431): Increased breadth of the nasal bridge (and with it, the nasal root). Evidence: TAS. Frequency: Occasional (HP:0040283). (ORPHA:99843)
- Depressed nasal ridge (HP:0000457): Lack of prominence of the nose resulting from a posteriorly-placed nasal ridge. Evidence: TAS. Frequency: Occasional (HP:0040283). (ORPHA:99843)
- Keratitis (HP:0000491): Inflammation of the cornea. Evidence: TAS. Frequency: Occasional (HP:0040283). (ORPHA:99843)
- Long eyelashes (HP:0000527): Mid upper eyelash length >10 mm or increased length of the eyelashes (subjective). Evidence: TAS. Frequency: Occasional (HP:0040283). (ORPHA:99843)
- Broad palm (HP:0001169): For children from birth to 4 years of age the palm width is more than 2 SD above the mean; for children from 4 to 16 years of age the palm width is above the 95th centile; or, the width of the palm appears disproportionately wide for the length. Evidence: TAS. Frequency: Occasional (HP:0040283). (ORPHA:99843)
- Ataxia (HP:0001251): Ataxia refers to impaired coordination of voluntary muscle movement. Cerebellar ataxia refers to ataxia due to dysfunction of the cerebellum. This causes a variety of elementary neurological deficits including asynergy (lack of coordination between muscles, limbs and joints), dysmetria (lack of ability to judge distances that can lead to under- or overshoot in grasping movements), and dysdiadochokinesia (inability to perform rapid movements requiring antagonizing muscle groups to be switched on and off repeatedly). Evidence: TAS. Frequency: Occasional (HP:0040283). (ORPHA:99843)
- Generalized hypotonia (HP:0001290): Generalized muscular hypotonia (abnormally low muscle tone). Evidence: TAS. Frequency: Occasional (HP:0040283). (ORPHA:99843)
- Hyperreflexia (HP:0001347): Hyperreflexia is the presence of hyperactive stretch reflexes of the muscles. Evidence: TAS. Frequency: Occasional (HP:0040283). (ORPHA:99843)
- Umbilical hernia (HP:0001537): Protrusion of abdominal contents through a defect in the abdominal wall musculature around the umbilicus. Skin and subcutaneous tissue overlie the defect. Evidence: TAS. Frequency: Occasional (HP:0040283). (ORPHA:99843)
- Overlapping toe (HP:0001845): Describes a foot digit resting on the dorsal surface of an adjacent digit when the foot is at rest. Initially clawing may be dynamic and only noticeable on walking. Over time the plantar plate tears, subluxation occurs at the metatarsophalangeal joint (MTPJ), and the deformity becomes permanent. Evidence: TAS. Frequency: Occasional (HP:0040283). (ORPHA:99843)
- Deep philtrum (HP:0002002): Accentuated, prominent philtral ridges giving rise to an exaggerated groove in the midline between the nasal base and upper vermillion border. Evidence: TAS. Frequency: Occasional (HP:0040283). (ORPHA:99843)
- Chronic diarrhea (HP:0002028): The presence of chronic diarrhea, which is usually taken to mean diarrhea that has persisted for over 4 weeks. Evidence: TAS. Frequency: Occasional (HP:0040283). (ORPHA:99843)
- Hepatomegaly (HP:0002240): Abnormally increased size of the liver. Evidence: TAS. Frequency: Occasional (HP:0040283). (ORPHA:99843)
- Depressed nasal bridge (HP:0005280): Posterior positioning of the nasal root in relation to the overall facial profile for age. Evidence: TAS. Frequency: Occasional (HP:0040283). (ORPHA:99843)
- Premature loss of teeth (HP:0006480): Exfoliation of a tooth more than 2 SD earlier than the normal age for the deciduous teeth and not related to traume or neglect. Exfoliation of a permanent tooth is per se abnormal. Evidence: TAS. Frequency: Occasional (HP:0040283). (ORPHA:99843)
- Recurrent pneumonia (HP:0006532): An increased susceptibility to pneumonia as manifested by a history of recurrent episodes of pneumonia. Evidence: TAS. Frequency: Occasional (HP:0040283). (ORPHA:99843)
- Lower limb hypertonia (HP:0006895). Evidence: TAS. Frequency: Occasional (HP:0040283). (ORPHA:99843)
- Chronic lymphocytic meningitis (HP:0007041): Meningitis that persists for more than 4 weeks, and lymphocytes are present in the cerebrospinal fluid (CSF). Evidence: TAS. Frequency: Occasional (HP:0040283). (ORPHA:99843)
- Hypoplasia of the frontal lobes (HP:0007333): Underdevelopment of the frontal lobe of the cerebrum. Evidence: TAS. Frequency: Occasional (HP:0040283). (ORPHA:99843)
- Microtia (HP:0008551): Underdevelopment of the external ear. Evidence: TAS. Frequency: Occasional (HP:0040283). (ORPHA:99843)
- Limb undergrowth (HP:0009826): Limb shortening because of underdevelopment of one or more bones of the extremities. Evidence: TAS. Frequency: Occasional (HP:0040283). (ORPHA:99843)
- Protruding tongue (HP:0010808): Tongue extending beyond the alveolar ridges or teeth at rest. Evidence: TAS. Frequency: Occasional (HP:0040283). (ORPHA:99843)
- Broad eyebrow (HP:0011229): Regional increase in the width (height) of the eyebrow. Evidence: TAS. Frequency: Occasional (HP:0040283). (ORPHA:99843)
- Long upper lip (HP:0011341): Increased width of the upper lip. Evidence: TAS. Frequency: Occasional (HP:0040283). (ORPHA:99843)
- Esodeviation (HP:0020045): A manifest or latent ocular deviation in which one or both eyes tends to deviate nasally. Evidence: TAS. Frequency: Occasional (HP:0040283). (ORPHA:99843)
- Recurrent gastroenteritis (HP:0031123): Increased susceptibility to gastroenteritis, an infectious inflammationof the stomach and small intestines manifested by signs and symptoms such as diarheas and abdominal pain, as manifested by recurrent episodes of gastroenteritis. Evidence: TAS. Frequency: Occasional (HP:0040283). (ORPHA:99843)
- Impaired tandem gait (HP:0031629): Reduced ability to walk in a straight line while placing the feet heel to toe. Evidence: TAS. Frequency: Occasional (HP:0040283). (ORPHA:99843)
- Palpebral edema (HP:0100540): Edema in the region of the eyelids. Evidence: TAS. Frequency: Occasional (HP:0040283). (ORPHA:99843)
- Scarring (HP:0100699): A scar refers to a lesion in which wound, burn, or sore has not healed completely and fibrous connective tissue has developed. Evidence: TAS. Frequency: Occasional (HP:0040283). (ORPHA:99843)
- Skin vesicle (HP:0200037): A circumscribed, fluid-containing, epidermal elevation less than 10mm in diameter at the widest point that (i) Contain serous exudates or serum mixed with blood or pus; (ii) Are discrete, grouped, irregularly distributed, or linear as in Rhus dermatitis; (iii) Are short-lived. Vesicles may break spontaneously or evolve into bullae by enlarging or coalescing with other vesicles. Evidence: TAS. Frequency: Occasional (HP:0040283). (ORPHA:99843)
- Coarse facial features (HP:0000280): Absence of fine and sharp appearance of brows, nose, lips, mouth, and chin, usually because of rounded and heavy features or thickened skin with or without thickening of subcutaneous and bony tissues. Evidence: TAS. Frequency: Very frequent (HP:0040281). (ORPHA:99843)
- Failure to thrive (HP:0001508): Failure to thrive (FTT) refers to a child whose physical growth is substantially below the norm. Evidence: TAS. Frequency: Very frequent (HP:0040281). (ORPHA:99843)
- Anemia (HP:0001903): A reduction in erythrocytes volume or hemoglobin concentration. Evidence: TAS. Frequency: Very frequent (HP:0040281). (ORPHA:99843)
- Increased total leukocyte count (HP:0001974): An abnormal increase in the number of leukocytes in the blood. Evidence: TAS. Frequency: Very frequent (HP:0040281). (ORPHA:99843)
- Recurrent infections (HP:0002719): Increased susceptibility to infections as manifested by repeated bouts of infection. Evidence: TAS. Frequency: Very frequent (HP:0040281). (ORPHA:99843)
- Short stature (HP:0004322): A height below that which is expected according to age and gender norms. Although there is no universally accepted definition of short stature, many refer to "short stature" as height more than 2 standard deviations below the mean for age and gender (or below the 3rd percentile for age and gender dependent norms). Evidence: TAS. Frequency: Very frequent (HP:0040281). (ORPHA:99843)
- Increased total neutrophil count (HP:0011897): Abnormal increase of absolute number of neutrophils in the blood, per microliter, compared to a reference range for a given sex and age-group. Evidence: TAS. Frequency: Very frequent (HP:0040281). (ORPHA:99843)
- Abnormal circulating isohemagglutinin concentration (HP:0410292): An abnormal level of isohemagglutinin in the blood. An isohemagglutinin refers to the naturally occurring antibodies in the ABO blood group system (i.e., anti-A in a group B person, anti-B in a group A person, and anti-A, anti-B, and anti-A,B in a group O person). Evidence: TAS. Frequency: Very frequent (HP:0040281). (ORPHA:99843)
- Autistic behavior (HP:0000729): Persistent deficits in social interaction and communication and interaction as well as a markedly restricted repertoire of activity and interest as well as repetitive patterns of behavior. Evidence: TAS. Frequency: Frequent (HP:0040282). (ORPHA:99843)
These phenotypes are associated with the disease Leukocyte adhesion deficiency type II (ORPHA:99843).